- Functional abnormality of the bladder (HP:0000009): Dysfunction of the urinary bladder. Evidence: TAS. Frequency: Very frequent (HP:0040281). (ORPHA:37202)
- Urinary urgency (HP:0000012): Urge incontinence is the strong, sudden need to urinate. Evidence: TAS. Frequency: Very frequent (HP:0040281). (ORPHA:37202)
- Abnormality of the bladder (HP:0000014): An abnormality of the urinary bladder. Evidence: TAS. Frequency: Very frequent (HP:0040281). (ORPHA:37202)
- Nocturia (HP:0000017): Abnormally increased production of urine during the night leading to an unusually frequent need to urinate. Evidence: TAS. Frequency: Very frequent (HP:0040281). (ORPHA:37202)
- Abnormal labia morphology (HP:0000058): An anomaly of the labia, the externally visible portions of the vulva. Evidence: TAS. Frequency: Very frequent (HP:0040281). (ORPHA:37202)
- Abnormality of the genital system (HP:0000078): An abnormality of the genital system. Evidence: TAS. Frequency: Very frequent (HP:0040281). (ORPHA:37202)
- Abnormality of the menstrual cycle (HP:0000140): An abnormality of the ovulation cycle. Evidence: TAS. Frequency: Very frequent (HP:0040281). (ORPHA:37202)
- Abnormality of the urethra (HP:0000795): An abnormality of the urethra, i.e., of the tube which connects the urinary bladder to the outside of the body. Evidence: TAS. Frequency: Very frequent (HP:0040281). (ORPHA:37202)
- Dyspareunia (HP:0030016): Recurrent or persistent genital pain associated with sexual intercourse. Evidence: TAS. Frequency: Very frequent (HP:0040281). (ORPHA:37202)
- Pelvic pain (HP:0034267): Pain perceived in the area of the pelvis, the lower part of the abdomen located between the hip bones. Evidence: TAS. Frequency: Very frequent (HP:0040281). (ORPHA:37202)
- Pollakisuria (HP:0100515): Increased frequency of urination. Evidence: TAS. Frequency: Very frequent (HP:0040281). (ORPHA:37202)
- Dysuria (HP:0100518): Painful or difficult urination. Evidence: TAS. Frequency: Very frequent (HP:0040281). (ORPHA:37202)
- Urinary bladder inflammation (HP:0100577): Inflammation of the urinary bladder. Evidence: TAS. Frequency: Very frequent (HP:0040281). (ORPHA:37202)
- Depression (HP:0000716): Frequently experiencing feelings of being down, miserable, and/or hopeless; struggling to recover from these moods; having a pessimistic outlook on the future; feeling a pervasive sense of shame; having a low self-worth; experiencing thoughts of suicide and engaging in suicidal behavior. Evidence: TAS. Frequency: Frequent (HP:0040282). (ORPHA:37202)
- Autoimmunity (HP:0002960): The occurrence of an immune reaction against the organism's own cells or tissues. Evidence: TAS. Frequency: Frequent (HP:0040282). (ORPHA:37202)
- Abnormality of tumor necrosis factor secretion (HP:0011118): An abnormality in the production or cellular release of tumor necrosis factor. Evidence: TAS. Frequency: Frequent (HP:0040282). (ORPHA:37202)
- Elevated circulating C-reactive protein concentration (HP:0011227): The concentration of C-reactive protein in the blood circulation is above the upper limit of normal. Evidence: TAS. Frequency: Frequent (HP:0040282). (ORPHA:37202)
- Abnormal vagina morphology (HP:0000142): Any structural abnormality of the vagina. Evidence: TAS. Frequency: Occasional (HP:0040283). (ORPHA:37202)
- Anal pain (HP:0500005): Pain in and around the anus or rectum (perianal region). Evidence: TAS. Frequency: Occasional (HP:0040283). (ORPHA:37202)
These phenotypes are associated with the disease Interstitial cystitis (ORPHA:37202).